Phenotypes associated with the disease Wilms tumor 3 (OMIM:194090):
- Nephroblastoma (HP:0002667): The presence of a nephroblastoma, which is a neoplasm of the kidney that primarily affects children. Evidence: IEA. (OMIM:194090)
- Autosomal dominant inheritance (HP:0000006): A mode of inheritance that is observed for traits related to a gene encoded on one of the autosomes (i.e., the human chromosomes 1-22) in which a trait manifests in heterozygotes. In the context of medical genetics, an autosomal dominant disorder is caused when a single copy of the mutant allele is present. Males and females are affected equally, and can both transmit the disorder with a risk of 50% for each child of inheriting the mutant allele. Evidence: IEA. (OMIM:194090)